- Ichthyosis (HP:0008064): An abnormality of the skin characterized the presence of excessive amounts of dry surface scales on the skin resulting from an abnormality of keratinization. Evidence: IEA. (OMIM:242520)
- Dysarthria (HP:0001260): Dysarthric speech is a general description referring to a neurological speech disorder characterized by poor articulation. Depending on the involved neurological structures, dysarthria may be further classified as spastic, flaccid, ataxic, hyperkinetic and hypokinetic, or mixed. Evidence: IEA. (OMIM:242520)
- Ataxia (HP:0001251): Ataxia refers to impaired coordination of voluntary muscle movement. Cerebellar ataxia refers to ataxia due to dysfunction of the cerebellum. This causes a variety of elementary neurological deficits including asynergy (lack of coordination between muscles, limbs and joints), dysmetria (lack of ability to judge distances that can lead to under- or overshoot in grasping movements), and dysdiadochokinesia (inability to perform rapid movements requiring antagonizing muscle groups to be switched on and off repeatedly). Evidence: IEA. (OMIM:242520)
- Autosomal recessive inheritance (HP:0000007): A mode of inheritance that is observed for traits related to a gene encoded on one of the autosomes (i.e., the human chromosomes 1-22) in which a trait manifests in individuals with two pathogenic alleles, either homozygotes (two copies of the same mutant allele) or compound heterozygotes (whereby each copy of a gene has a distinct mutant allele). Evidence: IEA. (OMIM:242520)
- Hepatosplenomegaly (HP:0001433): Simultaneous enlargement of the liver and spleen. Evidence: IEA. (OMIM:242520)
These phenotypes are associated with the disease ichthyosis-hepatosplenomegaly-cerebellar degeneration syndrome (OMIM:242520).